Phenotypes associated with the disease triphalangeal thumb, Nonopposable (OMIM:190600):
- Triphalangeal thumb (HP:0001199): A thumb with three phalanges in a single, proximo-distal axis. Thus, this term applies if the thumb has an accessory phalanx, leading to a digit like appearance of the thumb. Evidence: IEA. (OMIM:190600)
- Polydactyly (HP:0010442): A congenital anomaly characterized by the presence of supernumerary fingers or toes. Evidence: TAS. (OMIM:190600)
- Autosomal dominant inheritance (HP:0000006): A mode of inheritance that is observed for traits related to a gene encoded on one of the autosomes (i.e., the human chromosomes 1-22) in which a trait manifests in heterozygotes. In the context of medical genetics, an autosomal dominant disorder is caused when a single copy of the mutant allele is present. Males and females are affected equally, and can both transmit the disorder with a risk of 50% for each child of inheriting the mutant allele. Evidence: IEA. (OMIM:190600)